- Abnormal renal physiology (HP:0012211): An abnormal functionality of the kidney. Evidence: IEA. (OMIM:123550)
- Abnormality of blood and blood-forming tissues (HP:0001871): An abnormality of the hematopoietic system. Evidence: IEA. (OMIM:123550)
- Hematuria (HP:0000790): The presence of blood in the urine. Hematuria may be gross hematuria (visible to the naked eye) or microscopic hematuria (detected by dipstick or microscopic examination of the urine). Evidence: IEA. (OMIM:123550)
- Cryoglobulinemia (HP:0100778): Increased level of cryoglobulins in the blood. Cryoglobulins are abnormal immunoglobulins, especially IGG or IGM, that precipitate spontaneously when serum is cooled below 37 degrees Celsius. Evidence: TAS. (OMIM:123550)
- Hypertension (HP:0000822): The presence of chronic increased pressure in the systemic arterial system. Evidence: IEA. (OMIM:123550)
- Proteinuria (HP:0000093): Increased levels of protein in the urine. Evidence: IEA. (OMIM:123550)
- Anasarca (HP:0012050): An extreme form of generalized edema with widespread and massive edema due to effusion of fluid into the extracellular space. Evidence: TAS. (OMIM:123550)
- Autosomal dominant inheritance (HP:0000006): A mode of inheritance that is observed for traits related to a gene encoded on one of the autosomes (i.e., the human chromosomes 1-22) in which a trait manifests in heterozygotes. In the context of medical genetics, an autosomal dominant disorder is caused when a single copy of the mutant allele is present. Males and females are affected equally, and can both transmit the disorder with a risk of 50% for each child of inheriting the mutant allele. Evidence: IEA. (OMIM:123550)
- Elevated circulating creatinine concentration (HP:0003259): An increased amount of creatinine in the blood. Evidence: IEA. (OMIM:123550)
- Chronic kidney disease (HP:0012622): Functional anomaly of the kidney persisting for at least three months. Evidence: TAS. (OMIM:123550)
These phenotypes are associated with the disease Cryoglobulinemic vasculitis (OMIM:123550).